- Autosomal dominant inheritance (HP:0000006): A mode of inheritance that is observed for traits related to a gene encoded on one of the autosomes (i.e., the human chromosomes 1-22) in which a trait manifests in heterozygotes. In the context of medical genetics, an autosomal dominant disorder is caused when a single copy of the mutant allele is present. Males and females are affected equally, and can both transmit the disorder with a risk of 50% for each child of inheriting the mutant allele. Evidence: IEA. (OMIM:605429)
This phenotype is associated with the disease DEAFNESS, AUTOSOMAL RECESSIVE 26, MODIFIER OF; DFNB26M (OMIM:605429).